- Permanent atrial fibrillation (HP:0004754): Atrial fibrillation (AF) that cannot be successfully terminated by cardioversion, and longstanding (more than 1 year) AF, where cardioversion is not indicated or has not been attempted, is termed permanent. Evidence: PCS. Frequency: 1/10. (PMID:15368194)
- Middle age onset (HP:0003596): A type of adult onset with onset of symptoms at the age of 40 to 60 years. Evidence: PCS. Frequency: 3/4. (PMID:15368194)
- Late onset (HP:0003584): A type of adult onset with onset of symptoms after the age of 60 years. Evidence: PCS. Frequency: 1/4. (PMID:15368194)
- Atrial fibrillation (HP:0005110): An atrial arrhythmia characterized by disorganized atrial activity without discrete P waves on the surface EKG, but instead by an undulating baseline or more sharply circumscribed atrial deflections of varying amplitude an frequency ranging from 350 to 600 per minute. Evidence: PCS. Frequency: 9/9. (PMID:15368194)
- Palpitations (HP:0001962): A sensation that the heart is pounding or racing, which is a non-specific sign but may be a manifestation of arrhythmia. Evidence: PCS. Frequency: 9/10. (PMID:15368194)
- Paroxysmal atrial fibrillation (HP:0004757): Episodes of atrial fibrillation that typically last for several hours up to one day and terminate spontaneously. Evidence: PCS. Frequency: 3/10. (PMID:15368194)
- Premature atrial contractions (HP:0006699): A type of cardiac arrhythmia with premature atrial contractions or beats caused by signals originating from ectopic atrial sites. Evidence: PCS. Frequency: 10/10. (PMID:15368194)
- Autosomal dominant inheritance (HP:0000006): A mode of inheritance that is observed for traits related to a gene encoded on one of the autosomes (i.e., the human chromosomes 1-22) in which a trait manifests in heterozygotes. In the context of medical genetics, an autosomal dominant disorder is caused when a single copy of the mutant allele is present. Males and females are affected equally, and can both transmit the disorder with a risk of 50% for each child of inheriting the mutant allele. Evidence: PCS. (PMID:15368194)
These phenotypes are associated with the disease atrial fibrillation, familial, 4 (OMIM:611493).